- Recurrent corneal erosions (HP:0000495): The presence of recurrent corneal epithelial erosions. Although most corneal epithelial defects heal quickly, some may show recurrent ulcerations. Evidence: PCS. (PMID:26788030)
- Epiphora (HP:0009926): Abnormally increased lacrimation, that is, excessive tearing (watering eye). Evidence: PCS. (PMID:26788030)
- Photophobia (HP:0000613): Excessive sensitivity to light with the sensation of discomfort or pain in the eyes due to exposure to bright light. Evidence: PCS. (PMID:26788030)
- Autosomal dominant inheritance (HP:0000006): A mode of inheritance that is observed for traits related to a gene encoded on one of the autosomes (i.e., the human chromosomes 1-22) in which a trait manifests in heterozygotes. In the context of medical genetics, an autosomal dominant disorder is caused when a single copy of the mutant allele is present. Males and females are affected equally, and can both transmit the disorder with a risk of 50% for each child of inheriting the mutant allele. Evidence: PCS. (PMID:26788030)
These phenotypes are associated with the disease corneal dystrophy, Meesmann, 2 (OMIM:618767).